- Short stature (HP:0004322): A height below that which is expected according to age and gender norms. Although there is no universally accepted definition of short stature, many refer to "short stature" as height more than 2 standard deviations below the mean for age and gender (or below the 3rd percentile for age and gender dependent norms). Evidence: TAS. (OMIM:300505)
- X-linked recessive inheritance (HP:0001419): A mode of inheritance that is observed for recessive traits related to a gene encoded on the X chromosome. In the context of medical genetics, X-linked recessive disorders manifest in males (who have one copy of the X chromosome and are thus hemizygotes), but generally not in female heterozygotes who have one mutant and one normal allele. Evidence: TAS. (OMIM:300505)
- Broad forehead (HP:0000337): Width of the forehead or distance between the frontotemporales is more than two standard deviations above the mean (objective); or apparently increased distance between the two sides of the forehead. Evidence: TAS. (OMIM:300505)
- Intellectual disability (HP:0001249): The term intellectual disability or intellectual developmental disorder is used to describe significantly sub-average intellectual and adaptive functioning based on clinical assessment and as measured by individually administered, appropriately normed, standardized and validated tests of intellectual functioning and adaptive behavior, with onset during the developmental period from infancy through adolescence. Evidence: TAS. (OMIM:300505)
These phenotypes are associated with the disease intellectual disability, X-linked 84 (OMIM:300505).